- Hemolytic anemia (HP:0001878): A type of anemia caused by premature destruction of red blood cells (hemolysis). Evidence: TAS. Frequency: Very frequent (HP:0040281). (ORPHA:3203)
- Reticulocytosis (HP:0001923): An elevation in the number of reticulocytes (immature erythrocytes) in the peripheral blood circulation. Evidence: TAS. Frequency: Very frequent (HP:0040281). (ORPHA:3203)
- Stomatocytosis (HP:0004446): The presence of erythrocytes with a mouth-shaped (stoma) area of central pallor on peripheral blood smear. Evidence: TAS. Frequency: Very frequent (HP:0040281). (ORPHA:3203)
- Increased red cell osmotic fragility (HP:0005502). Evidence: TAS. Frequency: Very frequent (HP:0040281). (ORPHA:3203)
- Abnormal mean corpuscular volume (HP:0025065): A deviation from normal of the mean corpuscular volume, or mean cell volume (MCV) of red blood cells, usually taken to be 80 to 100 femtoliters. Evidence: TAS. Frequency: Very frequent (HP:0040281). (ORPHA:3203)
- Decreased mean corpuscular hemoglobin concentration (HP:0025547): A reduction from the normal range of the average amount of hemoglobin per red blood cell (27 to 31 picograms/cell). A reduced mean corpuscular hemoglobin (MCH) may indicate a hypochromic anemia, but the MCH may be normal if both the total hemoglobin and the red blood cell count are reduced. Evidence: TAS. Frequency: Very frequent (HP:0040281). (ORPHA:3203)
- Intermittent jaundice (HP:0001046): Jaundice that is sometimes present, sometimes not. Evidence: TAS. Frequency: Occasional (HP:0040283). (ORPHA:3203)
- Splenomegaly (HP:0001744): Abnormal increased size of the spleen. Evidence: TAS. Frequency: Occasional (HP:0040283). (ORPHA:3203)
- Abnormal thrombosis (HP:0001977): Venous or arterial thrombosis (formation of blood clots) of spontaneous nature and which cannot be fully explained by acquired risk (e.g. atherosclerosis). Evidence: TAS. Frequency: Occasional (HP:0040283). (ORPHA:3203)
- Anisocytosis (HP:0011273): Abnormally increased variability in the size of erythrocytes. Evidence: TAS. Frequency: Occasional (HP:0040283). (ORPHA:3203)
- Increased circulating lactate dehydrogenase concentration (HP:0025435): An elevated level of the enzyme lactate dehydrogenase in the blood circulation. Evidence: TAS. Frequency: Occasional (HP:0040283). (ORPHA:3203)
These phenotypes are associated with the disease Overhydrated hereditary stomatocytosis (ORPHA:3203).